- Abnormal nail morphology (HP:0001597): Abnormal structure or appearance of the nail. Evidence: IEA. (OMIM:102650)
- Adactyly (HP:0009776): The absence of all phalanges of all the digits of a limb and the associated soft tissues. Evidence: TAS. (OMIM:102650)
- Short thumb (HP:0009778): Hypoplasia (congenital reduction in size) of the thumb. Evidence: TAS. (OMIM:102650)
- Autosomal dominant inheritance (HP:0000006): A mode of inheritance that is observed for traits related to a gene encoded on one of the autosomes (i.e., the human chromosomes 1-22) in which a trait manifests in heterozygotes. In the context of medical genetics, an autosomal dominant disorder is caused when a single copy of the mutant allele is present. Males and females are affected equally, and can both transmit the disorder with a risk of 50% for each child of inheriting the mutant allele. Evidence: IEA. (OMIM:102650)
These phenotypes are associated with the disease adactylia, unilateral (OMIM:102650).